- High palate (HP:0000218): Height of the palate more than 2 SD above the mean (objective) or palatal height at the level of the first permanent molar more than twice the height of the teeth (subjective). Evidence: TAS. Frequency: Very frequent (HP:0040281). (ORPHA:314588)
- Global developmental delay (HP:0001263): A delay in the achievement of motor or mental milestones in the domains of development of a child, including motor skills, speech and language, cognitive skills, and social and emotional skills. This term should only be used to describe children younger than five years of age. Evidence: TAS. Frequency: Very frequent (HP:0040281). (ORPHA:314588)
- Growth abnormality (HP:0001507). Evidence: TAS. Frequency: Very frequent (HP:0040281). (ORPHA:314588)
- Abnormal facial shape (HP:0001999): An abnormal morphology (form) of the face or its components. Evidence: TAS. Frequency: Very frequent (HP:0040281). (ORPHA:314588)
- Abnormality of the kidney (HP:0000077): An abnormality of the kidney. Evidence: TAS. Frequency: Frequent (HP:0040282). (ORPHA:314588)
- Hydronephrosis (HP:0000126): Severe distention of the kidney with dilation of the renal pelvis and calices. Evidence: TAS. Frequency: Frequent (HP:0040282). (ORPHA:314588)
- Retrognathia (HP:0000278): An abnormality in which the mandible is mislocalised posteriorly. Evidence: TAS. Frequency: Frequent (HP:0040282). (ORPHA:314588)
- Hypertelorism (HP:0000316): Interpupillary distance more than 2 SD above the mean (alternatively, the appearance of an increased interpupillary distance or widely spaced eyes). Evidence: TAS. Frequency: Frequent (HP:0040282). (ORPHA:314588)
- Micrognathia (HP:0000347): Developmental hypoplasia of the mandible. Evidence: TAS. Frequency: Frequent (HP:0040282). (ORPHA:314588)
- Low-set ears (HP:0000369): Upper insertion of the ear to the scalp below an imaginary horizontal line drawn between the inner canthi of the eye and extending posteriorly to the ear. Evidence: TAS. Frequency: Frequent (HP:0040282). (ORPHA:314588)
- Telecanthus (HP:0000506): Distance between the inner canthi more than two standard deviations above the mean (objective); or, apparently increased distance between the inner canthi. Evidence: TAS. Frequency: Frequent (HP:0040282). (ORPHA:314588)
- Abnormal skull morphology (HP:0000929): An abnormality of the skull, the bony framework of the head which is comprised of the neurocranium (with eight cranial bones) and the viscerocranium (facial skeleton) that comprises fourteen facial bones with the mandible as its largest bone. Evidence: TAS. Frequency: Frequent (HP:0040282). (ORPHA:314588)
- Hypotonia (HP:0001252): Hypotonia is an abnormally low muscle tone (the amount of tension or resistance to movement in a muscle). Even when relaxed, muscles have a continuous and passive partial contraction which provides some resistance to passive stretching. Hypotonia thus manifests as diminished resistance to passive stretching. Hypotonia is not the same as muscle weakness, although the two conditions can co-exist. Evidence: TAS. Frequency: Frequent (HP:0040282). (ORPHA:314588)
- Specific learning disability (HP:0001328): Impairment of certain skills such as reading or writing, coordination, self-control, or attention that interfere with the ability to learn. The impairment is not related to a global deficiency of intelligence. Evidence: TAS. Frequency: Frequent (HP:0040282). (ORPHA:314588)
- Craniosynostosis (HP:0001363): Craniosynostosis refers to the premature closure of the cranial sutures. Primary craniosynostosis refers to the closure of one or more sutures due to abnormalities in skull development, and secondary craniosynostosis results from failure of brain growth. Evidence: TAS. Frequency: Frequent (HP:0040282). (ORPHA:314588)
- Large for gestational age (HP:0001520): The term large for gestational age applies to babies whose birth weight lies above the 90th percentile for that gestational age. Evidence: TAS. Frequency: Frequent (HP:0040282). (ORPHA:314588)
- Birth length greater than 97th percentile (HP:0003517). Evidence: TAS. Frequency: Frequent (HP:0040282). (ORPHA:314588)
- Hydrocele testis (HP:0000034): Accumulation of clear fluid in the between the layers of membrane (tunica vaginalis) surrounding the testis. Evidence: TAS. Frequency: Occasional (HP:0040283). (ORPHA:314588)
- Horseshoe kidney (HP:0000085): A connection of the right and left kidney by an isthmus of functioning renal parenchyma or fibrous tissue that crosses the midline. Evidence: TAS. Frequency: Occasional (HP:0040283). (ORPHA:314588)
- Polycystic kidney dysplasia (HP:0000113): The presence of multiple cysts in both kidneys. Evidence: TAS. Frequency: Occasional (HP:0040283). (ORPHA:314588)
- Hydrocephalus (HP:0000238): Hydrocephalus is an active distension of the ventricular system of the brain resulting from inadequate passage of CSF from its point of production within the cerebral ventricles to its point of absorption into the systemic circulation. Evidence: TAS. Frequency: Occasional (HP:0040283). (ORPHA:314588)
- Cupped ear (HP:0000378): Laterally protruding ear that lacks antihelical folding (including absence of inferior and superior crura). Evidence: TAS. Frequency: Occasional (HP:0040283). (ORPHA:314588)
- Sensorineural hearing impairment (HP:0000407): A type of hearing impairment in one or both ears related to an abnormal functionality of the cochlear nerve. Evidence: TAS. Frequency: Occasional (HP:0040283). (ORPHA:314588)
- Strabismus (HP:0000486): A misalignment of the eyes so that the visual axes deviate from bifoveal fixation. The classification of strabismus may be based on a number of features including the relative position of the eyes, whether the deviation is latent or manifest, intermittent or constant, concomitant or otherwise and according to the age of onset and the relevance of any associated refractive error. Evidence: TAS. Frequency: Occasional (HP:0040283). (ORPHA:314588)
- Abnormal sternum morphology (HP:0000766): An anomaly of the sternum, also known as the breastbone. Evidence: TAS. Frequency: Occasional (HP:0040283). (ORPHA:314588)
- Abnormal external genitalia morphology (HP:0000811): A structural anomaly of the external genitalia. Evidence: TAS. Frequency: Occasional (HP:0040283). (ORPHA:314588)
- Corneal dystrophy (HP:0001131): The term corneal dystrophy embraces a heterogenous group of bilateral genetically determined non-inflammatory corneal diseases that are restricted to the cornea. Evidence: TAS. Frequency: Occasional (HP:0040283). (ORPHA:314588)
- Arachnodactyly (HP:0001166): Abnormally long and slender fingers (spider fingers). Evidence: TAS. Frequency: Occasional (HP:0040283). (ORPHA:314588)
- Dandy-Walker malformation (HP:0001305): A congenital brain malformation typically characterized by incomplete formation of the cerebellar vermis, dilation of the fourth ventricle, and enlargement of the posterior fossa. In layman's terms, Dandy Walker malformation is a cyst in the cerebellum (typically symmetrical) that is involved with the fourth ventricle. This may interfere with the ability to drain cerebrospinal fluid from the brain, resulting in hydrocephalus. Dandy Walker cysts are formed during early embryonic development, while the brain forms. The cyst in the cerebellum typically has several blood vessels running through it connecting to the brain, thereby prohibiting surgical removal. Evidence: TAS. Frequency: Occasional (HP:0040283). (ORPHA:314588)
- Flexion contracture (HP:0001371): A flexion contracture is a bent (flexed) joint that cannot be straightened actively or passively. It is thus a chronic loss of joint motion due to structural changes in muscle, tendons, ligaments, or skin that prevents normal movement of joints. Evidence: TAS. Frequency: Occasional (HP:0040283). (ORPHA:314588)
- Intrauterine growth retardation (HP:0001511): An abnormal restriction of fetal growth with fetal weight below the tenth percentile for gestational age. Evidence: TAS. Frequency: Occasional (HP:0040283). (ORPHA:314588)
- Abnormal heart morphology (HP:0001627): Any structural anomaly of the heart. Evidence: TAS. Frequency: Occasional (HP:0040283). (ORPHA:314588)
- Atrial septal defect (HP:0001631): Atrial septal defect (ASD) is a congenital abnormality of the interatrial septum that enables blood flow between the left and right atria via the interatrial septum. Evidence: TAS. Frequency: Occasional (HP:0040283). (ORPHA:314588)
- Patent ductus arteriosus (HP:0001643): In utero, the ductus arteriosus (DA) serves to divert ventricular output away from the lungs and toward the placenta by connecting the main pulmonary artery to the descending aorta. A patent ductus arteriosus (PDA) in the first 3 days of life is a physiologic shunt in healthy term and preterm newborn infants, and normally is substantially closed within about 24 hours after bith and completely closed after about three weeks. Failure of physiologcal closure is referred to a persistent or patent ductus arteriosus (PDA). Depending on the degree of left-to-right shunting, PDA can have clinical consequences. Evidence: TAS. Frequency: Occasional (HP:0040283). (ORPHA:314588)
- Pulmonary hypoplasia (HP:0002089). Evidence: TAS. Frequency: Occasional (HP:0040283). (ORPHA:314588)
- Scoliosis (HP:0002650): The presence of an abnormal lateral curvature of the spine. Evidence: TAS. Frequency: Occasional (HP:0040283). (ORPHA:314588)
- Nephroblastoma (HP:0002667): The presence of a nephroblastoma, which is a neoplasm of the kidney that primarily affects children. Evidence: TAS. Frequency: Occasional (HP:0040283). (ORPHA:314588)
- Kyphosis (HP:0002808): Exaggerated anterior convexity of the thoracic vertebral column. Evidence: TAS. Frequency: Occasional (HP:0040283). (ORPHA:314588)
- Syringomyelia (HP:0003396): Dilated, glial-lined cavity in spinal cord. This cavity does not communicate with the central canal, and usually is between the dorsal columns unilaterally or bilaterally along the side of the cord. Evidence: TAS. Frequency: Occasional (HP:0040283). (ORPHA:314588)
- Microtia (HP:0008551): Underdevelopment of the external ear. Evidence: TAS. Frequency: Occasional (HP:0040283). (ORPHA:314588)
- Dilatation of the renal pelvis (HP:0010946): The presence of dilatation of the renal pelvis. Evidence: TAS. Frequency: Occasional (HP:0040283). (ORPHA:314588)
- Abnormal helix morphology (HP:0011039): An abnormality of the helix. The helix is the outer rim of the ear that extends from the insertion of the ear on the scalp (root) to the termination of the cartilage at the earlobe. Evidence: TAS. Frequency: Occasional (HP:0040283). (ORPHA:314588)
- Hypoplastic aortic arch (HP:0012304): Underdevelopment of the arch of aorta. Evidence: TAS. Frequency: Occasional (HP:0040283). (ORPHA:314588)
- Camptodactyly (HP:0012385): The distal interphalangeal joint and/or the proximal interphalangeal joint of the fingers or toes cannot be extended to 180 degrees by either active or passive extension. Evidence: TAS. Frequency: Occasional (HP:0040283). (ORPHA:314588)
- Hernia (HP:0100790). Evidence: TAS. Frequency: Occasional (HP:0040283). (ORPHA:314588)
These phenotypes are associated with the disease Distal triplication 15q syndrome (ORPHA:314588).